Phenotypes associated with the disease Becker muscular dystrophy (ORPHA:98895):
- Gait disturbance (HP:0001288): The term gait disturbance can refer to any disruption of the ability to walk. Evidence: TAS. Frequency: Very frequent (HP:0040281). (ORPHA:98895)
- Myoglobinuria (HP:0002913): Presence of myoglobin in the urine. Evidence: TAS. Frequency: Very frequent (HP:0040281). (ORPHA:98895)
- Elevated circulating creatine kinase activity (HP:0003236): The activity of creatine kinase in the blood circulation is above the upper limit of normal. Evidence: TAS. Frequency: Very frequent (HP:0040281). (ORPHA:98895)
- Myalgia (HP:0003326): Pain in muscle. Evidence: TAS. Frequency: Very frequent (HP:0040281). (ORPHA:98895)
- Exercise intolerance (HP:0003546): A functional motor deficit where individuals whose responses to the challenges of exercise fail to achieve levels considered normal for their age and gender. Evidence: TAS. Frequency: Very frequent (HP:0040281). (ORPHA:98895)
- Difficulty climbing stairs (HP:0003551): Reduced ability to climb stairs. Evidence: TAS. Frequency: Very frequent (HP:0040281). (ORPHA:98895)
- Abnormal urinary color (HP:0012086): An abnormal color of the urine, that is, the color of the urine appears different from the usual straw-yellow color. Evidence: TAS. Frequency: Very frequent (HP:0040281). (ORPHA:98895)
- Muscle weakness (HP:0001324): Reduced strength of muscles. Evidence: TAS. Frequency: Frequent (HP:0040282). (ORPHA:98895)
- Falls (HP:0002527). Evidence: TAS. Frequency: Frequent (HP:0040282). (ORPHA:98895)
- Abnormality of the lower limb (HP:0002814): An abnormality of the leg. Evidence: TAS. Frequency: Frequent (HP:0040282). (ORPHA:98895)
- Elevated circulating hepatic transaminase concentration (HP:0002910): Elevations of the levels of SGOT and SGPT in the serum. SGOT (serum glutamic oxaloacetic transaminase) and SGPT (serum glutamic pyruvic transaminase) are transaminases primarily found in the liver and heart and are released into the bloodstream as the result of liver or heart damage. SGOT and SGPT are used clinically mainly as markers of liver damage. Evidence: TAS. Frequency: Frequent (HP:0040282). (ORPHA:98895)
- Muscle spasm (HP:0003394): Sudden and involuntary contractions of one or more muscles. Evidence: TAS. Frequency: Frequent (HP:0040282). (ORPHA:98895)
- Fatigue (HP:0012378): A subjective feeling of tiredness characterized by a lack of energy and motivation. Evidence: TAS. Frequency: Frequent (HP:0040282). (ORPHA:98895)
- Pes planus (HP:0001763): A foot where the longitudinal arch of the foot is in contact with the ground or floor when the individual is standing; or, in a patient lying supine, a foot where the arch is in contact with the surface of a flat board pressed against the sole of the foot by the examiner with a pressure similar to that expected from weight bearing; or, the height of the arch is reduced. Evidence: TAS. Frequency: Occasional (HP:0040283). (ORPHA:98895)
- Skeletal muscle atrophy (HP:0003202): The presence of skeletal muscular atrophy (which is also known as amyotrophy). Evidence: TAS. Frequency: Occasional (HP:0040283). (ORPHA:98895)
- Tip-toe gait (HP:0030051): An abnormal gait pattern characterized by the failure of the heel to contact the floor at the onset of stance during gait. Evidence: TAS. Frequency: Occasional (HP:0040283). (ORPHA:98895)